Phenotypes associated with the disease Cronkhite-Canada syndrome (ORPHA:2930):
- Furrowed tongue (HP:0000221): Accentuation of the grooves on the dorsal surface of the tongue. Evidence: TAS. Frequency: Occasional (HP:0040283). (ORPHA:2930)
- Hypogeusia (HP:0000224): A decreased ability to perceive flavor. Evidence: TAS. Frequency: Occasional (HP:0040283). (ORPHA:2930)
- Macrocephaly (HP:0000256): Occipitofrontal (head) circumference greater than 97th centile compared to appropriate, age matched, sex-matched normal standards. Alternatively, a apparently increased size of the cranium. Evidence: TAS. Frequency: Occasional (HP:0040283). (ORPHA:2930)
- Cataract (HP:0000518): A cataract is an opacity or clouding that develops in the crystalline lens of the eye or in its capsule. Evidence: TAS. Frequency: Occasional (HP:0040283). (ORPHA:2930)
- Abnormal skin pigmentation (HP:0001000): An abnormality of the pigmentation of the skin. Evidence: TAS. Frequency: Very frequent (HP:0040281). (ORPHA:2930)
- Lymphedema (HP:0001004): Localized fluid retention and tissue swelling caused by a compromised lymphatic system. Evidence: TAS. Frequency: Frequent (HP:0040282). (ORPHA:2930)
- Tapered finger (HP:0001182): The gradual reduction in girth of the finger from proximal to distal. Evidence: TAS. Frequency: Occasional (HP:0040283). (ORPHA:2930)
- Abnormal fingernail morphology (HP:0001231): An abnormality of the fingernails. Evidence: TAS. Frequency: Very frequent (HP:0040281). (ORPHA:2930)
- Seizure (HP:0001250): A seizure is an intermittent abnormality of nervous system physiology characterized by a transient occurrence of signs and/or symptoms due to abnormal excessive or synchronous neuronal activity in the brain. Evidence: TAS. Frequency: Occasional (HP:0040283). (ORPHA:2930)
- Alopecia (HP:0001596): A noncongenital process of hair loss, which may progress to partial or complete baldness. Evidence: TAS. Frequency: Very frequent (HP:0040281). (ORPHA:2930)
- Splenomegaly (HP:0001744): Abnormal increased size of the spleen. Evidence: TAS. Frequency: Occasional (HP:0040283). (ORPHA:2930)
- Hypoplastic toenails (HP:0001800): Underdevelopment of the toenail. Evidence: TAS. Frequency: Very frequent (HP:0040281). (ORPHA:2930)
- Dystrophic toenail (HP:0001810): Toenail changes apart from changes of the color of the toenail (nail dyschromia) that involve partial or complete disruption of the various keratinous layers of the nail plate. Evidence: TAS. Frequency: Very frequent (HP:0040281). (ORPHA:2930)
- Anemia (HP:0001903): A reduction in erythrocytes volume or hemoglobin concentration. Evidence: TAS. Frequency: Frequent (HP:0040282). (ORPHA:2930)
- Diarrhea (HP:0002014): Abnormally increased frequency (usually defined as three or more) loose or watery bowel movements a day. Evidence: TAS. Frequency: Very frequent (HP:0040281). (ORPHA:2930)
- Malabsorption (HP:0002024): Impaired ability to absorb one or more nutrients from the intestine. Evidence: TAS. Frequency: Very frequent (HP:0040281). (ORPHA:2930)
- Abdominal pain (HP:0002027): An unpleasant sensation characterized by physical discomfort (such as pricking, throbbing, or aching) and perceived to originate in the abdomen. Evidence: TAS. Frequency: Frequent (HP:0040282). (ORPHA:2930)
- Anorexia (HP:0002039): Lack of desire to eat (loss of appetite). Evidence: TAS. Frequency: Frequent (HP:0040282). (ORPHA:2930)
- Sparse body hair (HP:0002231): Sparseness of the body hair. Evidence: TAS. Frequency: Frequent (HP:0040282). (ORPHA:2930)
- Patchy alopecia (HP:0002232): Transient, non-scarring hair loss and preservation of the hair follicle located in in well-defined patches. Evidence: TAS. Frequency: Very frequent (HP:0040281). (ORPHA:2930)
- Hepatomegaly (HP:0002240): Abnormally increased size of the liver. Evidence: TAS. Frequency: Occasional (HP:0040283). (ORPHA:2930)
- Abnormality of the vasculature (HP:0002597): An abnormality of the vasculature. Evidence: TAS. Frequency: Frequent (HP:0040282). (ORPHA:2930)
- Neoplasm (HP:0002664): An organ or organ-system abnormality that consists of uncontrolled autonomous cell-proliferation which can occur in any part of the body as a benign or malignant neoplasm (tumor). Evidence: TAS. Frequency: Occasional (HP:0040283). (ORPHA:2930)
- Gastrointestinal carcinoma (HP:0002672). Evidence: TAS. Frequency: Occasional (HP:0040283). (ORPHA:2930)
- Colon cancer (HP:0003003). Evidence: TAS. Frequency: Occasional (HP:0040283). (ORPHA:2930)
- Cachexia (HP:0004326): Severe weight loss, wasting of muscle, loss of appetite, and general debility related to a chronic disease. Evidence: TAS. Frequency: Frequent (HP:0040282). (ORPHA:2930)
- Hamartomatous polyposis (HP:0004390): Polyp-like protrusions which are histologically hamartomas. These can occur throughout the gastrointestinal tract. Hamartomatous polyps are composed of the normal cellular elements of the gastrointestinal tract, but have a markedly distorted architecture. Evidence: TAS. Frequency: Very frequent (HP:0040281). (ORPHA:2930)
- Generalized hyperpigmentation (HP:0007440). Evidence: TAS. Frequency: Very frequent (HP:0040281). (ORPHA:2930)
- Dystrophic fingernails (HP:0008391): The presence of misshapen or partially destroyed nail plates, often with accumulation of soft, yellow keratin between the dystrophic nail plate and nail bed, resulting in elevation of the nail plate. Evidence: TAS. Frequency: Very frequent (HP:0040281). (ORPHA:2930)
- Stomach cancer (HP:0012126): A cancer arising in any part of the stomach. Evidence: TAS. Frequency: Occasional (HP:0040283). (ORPHA:2930)
- Fatigue (HP:0012378): A subjective feeling of tiredness characterized by a lack of energy and motivation. Evidence: TAS. Frequency: Frequent (HP:0040282). (ORPHA:2930)
- Aplasia/Hypoplasia of the eyebrow (HP:0100840): Absence or underdevelopment of the eyebrow. Evidence: TAS. Frequency: Frequent (HP:0040282). (ORPHA:2930)
- Intestinal polyposis (HP:0200008): The presence of multiple polyps in the intestine. Evidence: TAS. Frequency: Very frequent (HP:0040281). (ORPHA:2930)